Phenotypes associated with the disease Parkinson disease 25, autosomal recessive early-onset, with impaired intellectual development (OMIM:620482):
- Resting tremor (HP:0002322): A resting tremor occurs when muscles are at rest and becomes less noticeable or disappears when the affected muscles are moved. Resting tremors are often slow and coarse. Evidence: PCS. Frequency: 2/4. (PMID:36073231)
- Juvenile onset (HP:0003621): Onset of signs or symptoms of disease between the age of 5 and 15 years. Evidence: PCS. Frequency: 4/4. (PMID:36073231)
- Restless legs (HP:0012452): An irresistible urge to move the legs, usually accompanied by unpleasant sensations deep within the limbs. Symptoms typically begin or worsen during periods of rest or inactivity, are most pronounced in the evening or at night, and are temporarily relieved by movement such as walking or stretching. The disturbance often interferes with the initiation or maintenance of sleep. Evidence: PCS. Frequency: 1/4. (PMID:36073231)
- Bradykinesia (HP:0002067): Bradykinesia literally means slow movement, and is used clinically to denote a slowness in the execution of movement (in contrast to hypokinesia, which is used to refer to slowness in the initiation of movement). Evidence: PCS. Frequency: 3/4. (PMID:36073231)
- Depression (HP:0000716): Frequently experiencing feelings of being down, miserable, and/or hopeless; struggling to recover from these moods; having a pessimistic outlook on the future; feeling a pervasive sense of shame; having a low self-worth; experiencing thoughts of suicide and engaging in suicidal behavior. Evidence: PCS. Frequency: 1/4. (PMID:36073231)
- Rigidity (HP:0002063): Continuous involuntary sustained muscle contraction. When an affected muscle is passively stretched, the degree of resistance remains constant regardless of the rate at which the muscle is stretched. This feature helps to distinguish rigidity from muscle spasticity. Evidence: PCS. Frequency: 1/4. (PMID:36073231)
- Anxiety (HP:0000739): Intense feelings of nervousness, tension, or panic often arise in response to interpersonal stresses. There is worry about the negative effects of past unpleasant experiences and future negative possibilities. Individuals may feel fearful, apprehensive, or threatened by uncertainty, and they may also have fears of falling apart or losing control. Evidence: PCS. Frequency: 1/4. (PMID:36073231)
- Disinhibition (HP:0000734): Reduced ability to control, or a failure to resist a temptation, urge, or impulse. Examples include disregard for social conventions, general impulsivity, and poor risk assessment. Evidence: PCS. Frequency: 1/4. (PMID:36073231)
- Autosomal recessive inheritance (HP:0000007): A mode of inheritance that is observed for traits related to a gene encoded on one of the autosomes (i.e., the human chromosomes 1-22) in which a trait manifests in individuals with two pathogenic alleles, either homozygotes (two copies of the same mutant allele) or compound heterozygotes (whereby each copy of a gene has a distinct mutant allele). Evidence: PCS. (PMID:36073231)
- Parkinsonism with favorable response to dopaminergic medication (HP:0002548): Parkinsonism is a clinical syndrome that is a feature of a number of different diseases, including Parkinson disease itself, other neurodegenerative diseases such as progressive supranuclear palsy, and as a side-effect of some neuroleptic medications. Some but not all individuals with Parkinsonism show responsiveness to dopaminergic medication defined as a substantial reduction of amelioration of the component signs of Parkinsonism (including mainly tremor, bradykinesia, rigidity, and postural instability) upon administration of dopaminergic medication. Evidence: PCS. Frequency: 4/4. (PMID:36073231)
- Drooling (HP:0002307): Habitual flow of saliva out of the mouth. Evidence: PCS. Frequency: 1/4. (PMID:36073231)
- Intellectual disability (HP:0001249): The term intellectual disability or intellectual developmental disorder is used to describe significantly sub-average intellectual and adaptive functioning based on clinical assessment and as measured by individually administered, appropriately normed, standardized and validated tests of intellectual functioning and adaptive behavior, with onset during the developmental period from infancy through adolescence. Evidence: PCS. Frequency: 4/4. (PMID:36073231)